Phenotypes associated with the disease 3-hydroxyisobutyryl-CoA hydrolase deficiency (OMIM:250620):
- Epicanthus (HP:0000286): A fold of skin starting above the medial aspect of the upper eyelid and arching downward to cover, pass in front of and lateral to the medial canthus. Evidence: TAS. (OMIM:250620)
- Lethargy (HP:0001254): A state of fatigue, either physical or mental slowness and sluggishness, with difficulties in initiating or performing simple tasks. Distinguished from apathy which implies indifference and a lack of desire or interest in the task. A person with lethargy may have the desire, but not the energy to engage in personal or socially relevant tasks. Evidence: PCS. Frequency: 1/1. (PMID:17160907)
- Strabismus (HP:0000486): A misalignment of the eyes so that the visual axes deviate from bifoveal fixation. The classification of strabismus may be based on a number of features including the relative position of the eyes, whether the deviation is latent or manifest, intermittent or constant, concomitant or otherwise and according to the age of onset and the relevance of any associated refractive error. Evidence: TAS. (OMIM:250620)
- Aminoaciduria (HP:0003355): An increased concentration of an amino acid in the urine. Evidence: IEA. (OMIM:250620)
- Dysmetria (HP:0001310): A type of ataxia characterized by the inability to carry out movements with the correct range and motion across the plane of more than one joint related to incorrect estimation of the distances required for targeted movements. Evidence: PCS. Frequency: 1/1. (PMID:17160907)
- Dystonia (HP:0001332): An abnormally increased muscular tone that causes fixed abnormal postures. There is a slow, intermittent twisting motion that leads to exaggerated turning and posture of the extremities and trunk. Evidence: TAS. (OMIM:250620)
- Seizure (HP:0001250): A seizure is an intermittent abnormality of nervous system physiology characterized by a transient occurrence of signs and/or symptoms due to abnormal excessive or synchronous neuronal activity in the brain. Evidence: TAS. (OMIM:250620)
- Agenesis of corpus callosum (HP:0001274): Absence of the corpus callosum as a result of the failure of the corpus callosum to develop, which can be the result of a failure in any one of the multiple steps of callosal development including cellular proliferation and migration, axonal growth or glial patterning at the midline. Evidence: PCS. Frequency: 1/1. (PMID:17160907)
- Hypotonia (HP:0001252): Hypotonia is an abnormally low muscle tone (the amount of tension or resistance to movement in a muscle). Even when relaxed, muscles have a continuous and passive partial contraction which provides some resistance to passive stretching. Hypotonia thus manifests as diminished resistance to passive stretching. Hypotonia is not the same as muscle weakness, although the two conditions can co-exist. Evidence: PCS. Frequency: 2/2. (PMID:17160907)
- Ataxia (HP:0001251): Ataxia refers to impaired coordination of voluntary muscle movement. Cerebellar ataxia refers to ataxia due to dysfunction of the cerebellum. This causes a variety of elementary neurological deficits including asynergy (lack of coordination between muscles, limbs and joints), dysmetria (lack of ability to judge distances that can lead to under- or overshoot in grasping movements), and dysdiadochokinesia (inability to perform rapid movements requiring antagonizing muscle groups to be switched on and off repeatedly). Evidence: PCS. Frequency: 1/1. (PMID:17160907)
- Infantile onset (HP:0003593): Onset of signs or symptoms of disease between 28 days to one year of life. Evidence: PCS. Frequency: 2/2. (PMID:17160907)
- Motor delay (HP:0001270): A type of Developmental delay characterized by a delay in acquiring motor skills. Evidence: PCS. Frequency: 1/1. (PMID:17160907)
- Reduced circulating 3-hydroxyisobutyryl-CoA hydrolase activity (HP:6000215): The activity of 3-hydroxyisobutyryl-CoA hydrolase in the blood corculation is below the lower limit of normal. Evidence: TAS. (OMIM:250620)
- Failure to thrive (HP:0001508): Failure to thrive (FTT) refers to a child whose physical growth is substantially below the norm. Evidence: PCS. Frequency: 1/1. (PMID:17160907)
- Nystagmus (HP:0000639): Rhythmic, involuntary oscillations of one or both eyes related to abnormality in fixation, conjugate gaze, or vestibular mechanisms. Evidence: PCS. Frequency: 1/1. (PMID:17160907)
- Irritability (HP:0000737): An emotional state characterized by negative feelings of heightened frustration, annoyance, or feeling upset, often triggered by internal factors (e.g., fatigue, hunger, unfulfilled desires) or external factors (e.g., social or environmental challenges). Irritability may be unpredictable, and is accompanied by a lowered threshold for emotional reactivity and observable features (speech, facial expressions, or psychomotor activity). Evidence: PCS. Frequency: 1/1. (PMID:17160907)
- Abnormal vertebral morphology (HP:0003468): An abnormality of one or more of the vertebrae. Evidence: TAS. (OMIM:250620)
- Head titubation (HP:0002599): A head tremor of moderate speed (3 to 4 Hz) in the anterior-posterior direction. Evidence: PCS. Frequency: 1/1. (PMID:17160907)
- Truncal ataxia (HP:0002078): Truncal ataxia is a sign of ataxia characterized by instability of the trunk. It usually occurs during sitting. Evidence: PCS. Frequency: 1/1. (PMID:17160907)
- Developmental regression (HP:0002376): Loss of developmental skills, as manifested by loss of developmental milestones. Evidence: PCS. Frequency: 1/1. (PMID:17160907)
- Feeding difficulties (HP:0011968): Impaired ability to eat related to problems gathering food and getting ready to suck, chew, or swallow it. Evidence: TAS. (OMIM:250620)
- Global developmental delay (HP:0001263): A delay in the achievement of motor or mental milestones in the domains of development of a child, including motor skills, speech and language, cognitive skills, and social and emotional skills. This term should only be used to describe children younger than five years of age. Evidence: TAS. (OMIM:250620)
- Abnormality of the vertebral column (HP:0000925): Any abnormality of the vertebral column. Evidence: IEA. (OMIM:250620)
- Tetralogy of Fallot (HP:0001636): A congenital cardiac malformation comprising pulmonary stenosis, overriding aorta, ventricular septum defect, and right ventricular hypertrophy. The diagnosis of TOF is made if at least three of the four above mentioned features are present. Evidence: PCS. Frequency: 1/1. (PMID:17160907)
- Autosomal recessive inheritance (HP:0000007): A mode of inheritance that is observed for traits related to a gene encoded on one of the autosomes (i.e., the human chromosomes 1-22) in which a trait manifests in individuals with two pathogenic alleles, either homozygotes (two copies of the same mutant allele) or compound heterozygotes (whereby each copy of a gene has a distinct mutant allele). Evidence: PCS. (PMID:17160907)
- Myoclonus (HP:0001336): Very brief, involuntary random muscular contractions occurring at rest, in response to sensory stimuli, or accompanying voluntary movements. Evidence: TAS. (OMIM:250620)